- Bronchiectasis (HP:0002110): Persistent abnormal dilatation of the bronchi owing to localized and irreversible destruction and widening of the large airways. Evidence: TAS. Frequency: Frequent (HP:0040282). (ORPHA:922)
- Chronic rhinitis (HP:0002257): Chronic inflammation of the nasal mucosa. Evidence: TAS. Frequency: Frequent (HP:0040282). (ORPHA:922)
- Recurrent upper respiratory tract infections (HP:0002788): An increased susceptibility to upper respiratory tract infections as manifested by a history of recurrent upper respiratory tract infections (running ears - otitis, sinusitis, pharyngitis, tonsillitis). Evidence: TAS. Frequency: Frequent (HP:0040282). (ORPHA:922)
- Abnormal respiratory motile cilium morphology (HP:0005938): Abnormal arrangement of the structures of the motile cilium. Evidence: TAS. Frequency: Frequent (HP:0040282). (ORPHA:922)
- Dyspnea (HP:0002094): Difficult or labored breathing. Dyspnea is a subjective feeling only the patient can rate, e.g., on a Borg scale. Evidence: TAS. Frequency: Occasional (HP:0040283). (ORPHA:922)
- Respiratory distress (HP:0002098): Respiratory distress is objectively observable as the physical or emotional consequences from the experience of dyspnea. The physical presentation of respiratory distress is generally referred to as labored breathing, while the sensation of respiratory distress is called shortness of breath or dyspnea. Evidence: TAS. Frequency: Occasional (HP:0040283). (ORPHA:922)
- Chronic sinusitis (HP:0011109): A chronic form of sinusitis. Evidence: TAS. Frequency: Occasional (HP:0040283). (ORPHA:922)
- Atelectasis (HP:0100750): Collapse of part of a lung associated with absence of inflation (air) of that part. Evidence: TAS. Frequency: Occasional (HP:0040283). (ORPHA:922)
These phenotypes are associated with the disease Familial nasal acilia (ORPHA:922).